- Poor speech (HP:0002465). Evidence: PCS. Frequency: 1/1. (PMID:23033978)
- Narrow forehead (HP:0000341): Width of the forehead or distance between the frontotemporales is more than two standard deviations below the mean (objective); or apparently narrow intertemporal region (subjective). Evidence: PCS. Frequency: 1/1. (PMID:23033978)
- Strabismus (HP:0000486): A misalignment of the eyes so that the visual axes deviate from bifoveal fixation. The classification of strabismus may be based on a number of features including the relative position of the eyes, whether the deviation is latent or manifest, intermittent or constant, concomitant or otherwise and according to the age of onset and the relevance of any associated refractive error. Evidence: PCS. Frequency: 1/1. (PMID:23033978)
- Short foot (HP:0001773): A measured foot length that is more than 2 SD below the mean for a newborn of 27 - 41 weeks gestation, or foot that is less than the 3rd centile for individuals from birth to 16 years of age (objective). Alternatively, a foot that appears disproportionately short (subjective). Evidence: PCS. Frequency: 1/1. (PMID:23033978)
- Long philtrum (HP:0000343): Distance between nasal base and midline upper lip vermilion border more than 2 SD above the mean. Alternatively, an apparently increased distance between nasal base and midline upper lip vermilion border. Evidence: IEA. (OMIM:618522)
- Short stature (HP:0004322): A height below that which is expected according to age and gender norms. Although there is no universally accepted definition of short stature, many refer to "short stature" as height more than 2 standard deviations below the mean for age and gender (or below the 3rd percentile for age and gender dependent norms). Evidence: PCS. Frequency: 1/1. (PMID:23033978)
- Brachydactyly (HP:0001156): Digits that appear disproportionately short compared to the hand/foot. The word brachydactyly is used here to describe a series distinct patterns of shortened digits (brachydactyly types A-E). This is the sense used here. Evidence: IEA. (OMIM:618522)
- Seizure (HP:0001250): A seizure is an intermittent abnormality of nervous system physiology characterized by a transient occurrence of signs and/or symptoms due to abnormal excessive or synchronous neuronal activity in the brain. Evidence: PCS. Frequency: 0/1. (PMID:23033978)
- Infantile onset (HP:0003593): Onset of signs or symptoms of disease between 28 days to one year of life. Evidence: PCS. Frequency: 1/1. (PMID:23033978)
- Generalized hypotonia (HP:0001290): Generalized muscular hypotonia (abnormally low muscle tone). Evidence: IEA. (OMIM:618522)
- Flat face (HP:0012368): Absence of concavity or convexity of the face when viewed in profile. Evidence: PCS. Frequency: 1/1. (PMID:23033978)
- Severe intellectual disability (HP:0010864): Severe intellectual disability (ID) is defined as a type of ID characterized by severely sub-average adaptive functioning and intellectual functioning, with an intelligence quotient (IQ) the range of 20-34. Evidence: PCS. Frequency: 1/1. (PMID:23033978)
- Fragile nails (HP:0001808): Nails that easily break. Evidence: IEA. Frequency: Very rare (HP:0040284). (OMIM:618522)
- Long palpebral fissure (HP:0000637): Distance between medial and lateral canthi is more than two standard deviations above the mean for age (objective); or, apparently increased length of the palpebral fissures. Evidence: PCS. Frequency: 1/1. (PMID:23033978)
- Protruding ear (HP:0000411): Angle formed by the plane of the ear and the mastoid bone greater than the 97th centile for age (objective); or, outer edge of the helix more than 2 cm from the mastoid at the point of maximum distance (objective). Evidence: IEA. (OMIM:618522)
- Macrocephaly (HP:0000256): Occipitofrontal (head) circumference greater than 97th centile compared to appropriate, age matched, sex-matched normal standards. Alternatively, a apparently increased size of the cranium. Evidence: IEA. (OMIM:618522)
- Mild short stature (HP:0003502): A mild degree of short stature, more than -2 SD but not more than -3 SD from mean corrected for age and sex. Evidence: IEA. (OMIM:618522)
- Highly arched eyebrow (HP:0002553): Increased height of the central portion of the eyebrow, forming a crescent, semicircular, or inverted U shape. Evidence: PCS. Frequency: 1/1. (PMID:23033978)
- Facial hypotonia (HP:0000297): Reduced muscle tone of a muscle that is innervated by the facial nerve (the seventh cranial nerve). Evidence: IEA. (OMIM:618522)
- Short palm (HP:0004279): Short palm. Evidence: PCS. Frequency: 1/1. (PMID:23033978)
- Delayed speech and language development (HP:0000750): A degree of language development that is significantly below the norm for a child of a specified age. Evidence: PCS. Frequency: 1/1. (PMID:23033978)
- Global developmental delay (HP:0001263): A delay in the achievement of motor or mental milestones in the domains of development of a child, including motor skills, speech and language, cognitive skills, and social and emotional skills. This term should only be used to describe children younger than five years of age. Evidence: PCS. Frequency: 1/1. (PMID:23033978)
- High forehead (HP:0000348): An abnormally increased height of the forehead. Evidence: IEA. (OMIM:618522)
- Sacral dimple (HP:0000960): A cutaneous indentation resulting from tethering of the skin to underlying structures (bone) of the intergluteal cleft. Evidence: PCS. Frequency: 1/1. (PMID:23033978)
- Myopia (HP:0000545): An abnormality of refraction characterized by the ability to see objects nearby clearly, while objects in the distance appear blurry. Evidence: PCS. Frequency: 1/1. (PMID:23033978)
- Low-set ears (HP:0000369): Upper insertion of the ear to the scalp below an imaginary horizontal line drawn between the inner canthi of the eye and extending posteriorly to the ear. Evidence: IEA. (OMIM:618522)
- Autosomal dominant inheritance (HP:0000006): A mode of inheritance that is observed for traits related to a gene encoded on one of the autosomes (i.e., the human chromosomes 1-22) in which a trait manifests in heterozygotes. In the context of medical genetics, an autosomal dominant disorder is caused when a single copy of the mutant allele is present. Males and females are affected equally, and can both transmit the disorder with a risk of 50% for each child of inheriting the mutant allele. Evidence: PCS. (PMID:23033978)
- Self-mutilation (HP:0000742): Deliberate harm to one's body resulting in tissue damage, without a conscious intent to die. Evidence: PCS. Frequency: 1/1. (PMID:23033978)
- Flat forehead (HP:0004425): A forehead with abnormal flatness. Evidence: IEA. (OMIM:618522)
These phenotypes are associated with the disease intellectual developmental disorder 59 (OMIM:618522).